- Downslanted palpebral fissures (HP:0000494): The palpebral fissure inclination is more than two standard deviations below the mean. Evidence: TAS. Frequency: Very frequent (HP:0040281). (ORPHA:280)
- Hypodontia (HP:0000668): The absence of five or less teeth from the normal series by a failure to develop. Evidence: TAS. Frequency: Very frequent (HP:0040281). (ORPHA:280)
- Seizure (HP:0001250): A seizure is an intermittent abnormality of nervous system physiology characterized by a transient occurrence of signs and/or symptoms due to abnormal excessive or synchronous neuronal activity in the brain. Evidence: TAS. Frequency: Very frequent (HP:0040281). (ORPHA:280)
- Ataxia (HP:0001251): Ataxia refers to impaired coordination of voluntary muscle movement. Cerebellar ataxia refers to ataxia due to dysfunction of the cerebellum. This causes a variety of elementary neurological deficits including asynergy (lack of coordination between muscles, limbs and joints), dysmetria (lack of ability to judge distances that can lead to under- or overshoot in grasping movements), and dysdiadochokinesia (inability to perform rapid movements requiring antagonizing muscle groups to be switched on and off repeatedly). Evidence: TAS. Frequency: Very frequent (HP:0040281). (ORPHA:280)
- Hypotonia (HP:0001252): Hypotonia is an abnormally low muscle tone (the amount of tension or resistance to movement in a muscle). Even when relaxed, muscles have a continuous and passive partial contraction which provides some resistance to passive stretching. Hypotonia thus manifests as diminished resistance to passive stretching. Hypotonia is not the same as muscle weakness, although the two conditions can co-exist. Evidence: TAS. Frequency: Very frequent (HP:0040281). (ORPHA:280)
- Global developmental delay (HP:0001263): A delay in the achievement of motor or mental milestones in the domains of development of a child, including motor skills, speech and language, cognitive skills, and social and emotional skills. This term should only be used to describe children younger than five years of age. Evidence: TAS. Frequency: Very frequent (HP:0040281). (ORPHA:280)
- Failure to thrive (HP:0001508): Failure to thrive (FTT) refers to a child whose physical growth is substantially below the norm. Evidence: TAS. Frequency: Very frequent (HP:0040281). (ORPHA:280)
- Intrauterine growth retardation (HP:0001511): An abnormal restriction of fetal growth with fetal weight below the tenth percentile for gestational age. Evidence: TAS. Frequency: Very frequent (HP:0040281). (ORPHA:280)
- Decreased fetal movement (HP:0001558): An abnormal reduction in quantity or strength of fetal movements. Evidence: TAS. Frequency: Very frequent (HP:0040281). (ORPHA:280)
- Frontal bossing (HP:0002007): Bilateral bulging of the lateral frontal bone prominences with relative sparing of the midline. Evidence: TAS. Frequency: Very frequent (HP:0040281). (ORPHA:280)
- Low posterior hairline (HP:0002162): Hair on the neck extends more inferiorly than usual. Evidence: TAS. Frequency: Very frequent (HP:0040281). (ORPHA:280)
- Highly arched eyebrow (HP:0002553): Increased height of the central portion of the eyebrow, forming a crescent, semicircular, or inverted U shape. Evidence: TAS. Frequency: Very frequent (HP:0040281). (ORPHA:280)
- Downturned corners of mouth (HP:0002714): A morphological abnormality of the mouth in which the angle of the mouth is downturned. The oral commissures are positioned inferior to the midline labial fissure. Evidence: TAS. Frequency: Very frequent (HP:0040281). (ORPHA:280)
- Microtia (HP:0008551): Underdevelopment of the external ear. Evidence: TAS. Frequency: Very frequent (HP:0040281). (ORPHA:280)
- High anterior hairline (HP:0009890): Distance between the hairline (trichion) and the glabella (the most prominent point on the frontal bone above the root of the nose), in the midline, more than two SD above the mean. Alternatively, an apparently increased distance between the hairline and the glabella. Evidence: TAS. Frequency: Very frequent (HP:0040281). (ORPHA:280)
- Severe intellectual disability (HP:0010864): Severe intellectual disability (ID) is defined as a type of ID characterized by severely sub-average adaptive functioning and intellectual functioning, with an intelligence quotient (IQ) the range of 20-34. Evidence: TAS. Frequency: Very frequent (HP:0040281). (ORPHA:280)
- Cryptorchidism (HP:0000028): Testis in inguinal canal. That is, absence of one or both testes from the scrotum owing to failure of the testis or testes to descend through the inguinal canal to the scrotum. Evidence: TAS. Frequency: Frequent (HP:0040282). (ORPHA:280)
- Abnormality of the kidney (HP:0000077): An abnormality of the kidney. Evidence: TAS. Frequency: Frequent (HP:0040282). (ORPHA:280)
- Cleft upper lip (HP:0000204): A gap or groove in the upper lip. This is a congenital defect resulting from nonfusion of tissues of the lip during embryonal development. Evidence: TAS. Frequency: Frequent (HP:0040282). (ORPHA:280)
- Hearing impairment (HP:0000365): A decreased magnitude of the sensory perception of sound. Evidence: TAS. Frequency: Frequent (HP:0040282). (ORPHA:280)
- Ptosis (HP:0000508): The upper eyelid margin is positioned 3 mm or more lower than usual and covers the superior portion of the iris (objective); or, the upper lid margin obscures at least part of the pupil (subjective). Evidence: TAS. Frequency: Frequent (HP:0040282). (ORPHA:280)
- Iris coloboma (HP:0000612): A coloboma of the iris. Evidence: TAS. Frequency: Frequent (HP:0040282). (ORPHA:280)
- Optic atrophy (HP:0000648): Atrophy of the optic nerve. Optic atrophy results from the death of the retinal ganglion cell axons that comprise the optic nerve and manifesting as a pale optic nerve on fundoscopy. Evidence: TAS. Frequency: Frequent (HP:0040282). (ORPHA:280)
- Taurodontia (HP:0000679): Increased volume of dental pulp of permanent molar characterized by a crown body-root ratio equal or larger than 1:1 or an elongated pulp chambers and apical displacement of the bifurcation or trifurcation of the roots. Evidence: TAS. Frequency: Frequent (HP:0040282). (ORPHA:280)
- Delayed eruption of teeth (HP:0000684): Delayed tooth eruption, which can be defined as tooth eruption more than 2 SD beyond the mean eruption age. Evidence: TAS. Frequency: Frequent (HP:0040282). (ORPHA:280)
- Abnormal thorax morphology (HP:0000765): Any abnormality of the thorax (the region of the body formed by the sternum, the thoracic vertebrae and the ribs). Evidence: TAS. Frequency: Frequent (HP:0040282). (ORPHA:280)
- Congenital diaphragmatic hernia (HP:0000776): The presence of a hernia of the diaphragm present at birth. Evidence: TAS. Frequency: Frequent (HP:0040282). (ORPHA:280)
- Rib fusion (HP:0000902): Complete or partial merging of adjacent ribs. Evidence: TAS. Frequency: Frequent (HP:0040282). (ORPHA:280)
- Abnormality of the vertebral column (HP:0000925): Any abnormality of the vertebral column. Evidence: TAS. Frequency: Frequent (HP:0040282). (ORPHA:280)
- Dry skin (HP:0000958): Skin characterized by the lack of natural or normal moisture. Evidence: TAS. Frequency: Frequent (HP:0040282). (ORPHA:280)
- Sacral dimple (HP:0000960): A cutaneous indentation resulting from tethering of the skin to underlying structures (bone) of the intergluteal cleft. Evidence: TAS. Frequency: Frequent (HP:0040282). (ORPHA:280)
- Hemangioma (HP:0001028): A hemangioma is a benign tumor characterized by blood-filled spaces lined by benign endothelial cells. A hemangioma characterized by large endothelial spaces (caverns) is called a cavernous hemangioma (in contrast to a hemangioma with small endothelial spaces, which is called capillary hemangioma). Evidence: TAS. Frequency: Frequent (HP:0040282). (ORPHA:280)
- Arachnodactyly (HP:0001166): Abnormally long and slender fingers (spider fingers). Evidence: TAS. Frequency: Frequent (HP:0040282). (ORPHA:280)
- Split hand (HP:0001171): A condition in which middle parts of the hand (fingers and metacarpals) are missing giving a cleft appearance. The severity is very variable ranging from slightly hypoplastic middle fingers over absent middle fingers as far as oligo- or monodactyl hands. Evidence: TAS. Frequency: Frequent (HP:0040282). (ORPHA:280)
- Preaxial hand polydactyly (HP:0001177): Supernumerary digits located at the radial side of the hand. Polydactyly (supernumerary digits) involving the thumb occurs in many distinct forms of high variability and severity. Ranging from fleshy nubbins over varying degrees of partial duplication/splitting to completely duplicated or even triplicated thumbs or preaxial (on the radial side of the hand) supernumerary digits. Evidence: TAS. Frequency: Frequent (HP:0040282). (ORPHA:280)
- Calvarial skull defect (HP:0001362): A localized defect in the bone of the skull resulting from abnormal embryological development. The defect is covered by normal skin. In some cases, skull x-rays have shown underlying lytic bone lesions which have closed before the age of one year. Evidence: TAS. Frequency: Frequent (HP:0040282). (ORPHA:280)
- Atrial septal defect (HP:0001631): Atrial septal defect (ASD) is a congenital abnormality of the interatrial septum that enables blood flow between the left and right atria via the interatrial septum. Evidence: TAS. Frequency: Frequent (HP:0040282). (ORPHA:280)
- Abnormal heart valve morphology (HP:0001654): Any structural abnormality of a cardiac valve. Evidence: TAS. Frequency: Frequent (HP:0040282). (ORPHA:280)
- Abnormal cardiac septum morphology (HP:0001671): An anomaly of the intra-atrial or intraventricular septum. Evidence: TAS. Frequency: Frequent (HP:0040282). (ORPHA:280)
- Abnormal foot morphology (HP:0001760): An abnormality of the skeleton of foot. Evidence: TAS. Frequency: Frequent (HP:0040282). (ORPHA:280)
- Talipes equinovarus (HP:0001762): Talipes equinovarus (also called clubfoot) typically has four main components: inversion and adduction of the forefoot; inversion of the heel and hindfoot; equinus (limitation of extension) of the ankle and subtalar joint; and internal rotation of the leg. Evidence: TAS. Frequency: Frequent (HP:0040282). (ORPHA:280)
- Tethered cord (HP:0002144): During normal embryological development, the spinal cord first occupies the entire length of the vertebral column but goes on to assume a position at the level of L1 due to differential growth of the conus medullaris and the vertebral column. The filum terminale is a slender, threadlike structure that remains after the normal regression of the distal embryonic spinal cord and attaches the spinal cord to the coccyx. A tethered cord results if there is a thickened rope-like filum terminale which anchors the cord at the level of L2 or below, potentially causing neurologic signs owing to abnormal tension on the spinal cord. Evidence: TAS. Frequency: Frequent (HP:0040282). (ORPHA:280)
- Sleep disturbance (HP:0002360): An abnormal pattern in the quality, quantity, or characteristics of sleep. Evidence: TAS. Frequency: Frequent (HP:0040282). (ORPHA:280)
- Scoliosis (HP:0002650): The presence of an abnormal lateral curvature of the spine. Evidence: TAS. Frequency: Frequent (HP:0040282). (ORPHA:280)
- Decreased circulating IgA concentration (HP:0002720): Decreased levels of immunoglobulin A (IgA). Evidence: TAS. Frequency: Frequent (HP:0040282). (ORPHA:280)
- Delayed skeletal maturation (HP:0002750): A decreased rate of skeletal maturation. Delayed skeletal maturation can be diagnosed on the basis of an estimation of the bone age from radiographs of specific bones in the human body. Evidence: TAS. Frequency: Frequent (HP:0040282). (ORPHA:280)
- Kyphosis (HP:0002808): Exaggerated anterior convexity of the thoracic vertebral column. Evidence: TAS. Frequency: Frequent (HP:0040282). (ORPHA:280)
- Abnormal vertebral body morphology (HP:0003312): Abnormal form of vertebral body, which is the central cylindrical portion of the vertebra that together with other structures such as the vertebral arch, pedicles, laminae, spinous process, transverse processes, and articular facets makes up a vertebra. Evidence: TAS. Frequency: Frequent (HP:0040282). (ORPHA:280)
- Abnormal vertebral morphology (HP:0003468): An abnormality of one or more of the vertebrae. Evidence: TAS. Frequency: Frequent (HP:0040282). (ORPHA:280)
- Preauricular pit (HP:0004467): Small indentation anterior to the insertion of the ear. Evidence: TAS. Frequency: Frequent (HP:0040282). (ORPHA:280)
- Rib segmentation abnormalities (HP:0006655). Evidence: TAS. Frequency: Frequent (HP:0040282). (ORPHA:280)
- Aplasia/Hypoplasia of the lungs (HP:0006703). Evidence: TAS. Frequency: Frequent (HP:0040282). (ORPHA:280)
- Aplasia cutis congenita of scalp (HP:0007385): A developmental defect resulting in the congenital absence of skin on the scalp. Evidence: TAS. Frequency: Frequent (HP:0040282). (ORPHA:280)
- Hypoplastic pubic ramus (HP:0008830): Underdevelopment of a ramus (branch) of the pubic bone. Evidence: TAS. Frequency: Frequent (HP:0040282). (ORPHA:280)
- Short thumb (HP:0009778): Hypoplasia (congenital reduction in size) of the thumb. Evidence: TAS. Frequency: Frequent (HP:0040282). (ORPHA:280)
- Short hallux (HP:0010109): Underdevelopment (hypoplasia) of the big toe. Evidence: TAS. Frequency: Frequent (HP:0040282). (ORPHA:280)
- Feeding difficulties (HP:0011968): Impaired ability to eat related to problems gathering food and getting ready to suck, chew, or swallow it. Evidence: TAS. Frequency: Frequent (HP:0040282). (ORPHA:280)
- Abnormal cardiovascular system morphology (HP:0030680): Any structural anomaly of the heart and blood vessels. Evidence: TAS. Frequency: Frequent (HP:0040282). (ORPHA:280)
- Abnormality of the genital system (HP:0000078): An abnormality of the genital system. Evidence: TAS. Frequency: Occasional (HP:0040283). (ORPHA:280)
- Abnormality of the urinary system (HP:0000079): An abnormality of the urinary system. Evidence: TAS. Frequency: Occasional (HP:0040283). (ORPHA:280)
- Aplasia of the uterus (HP:0000151): A congenital defect characterized by absence of the uterus. Aplasia refers to the failure of an organ to develop during embryonic growth and development due to the absence of primordial tissue. Evidence: TAS. Frequency: Occasional (HP:0040283). (ORPHA:280)
- Cleft palate (HP:0000175): Cleft palate is a developmental defect of the palate resulting from a failure of fusion of the palatine processes and manifesting as a separation of the roof of the mouth (soft and hard palate). Evidence: TAS. Frequency: Occasional (HP:0040283). (ORPHA:280)
- Chronic otitis media (HP:0000389): Chronic otitis media refers to fluid, swelling, or infection of the middle ear that does not heal and may cause permanent damage to the ear. Evidence: TAS. Frequency: Occasional (HP:0040283). (ORPHA:280)
- Megalocornea (HP:0000485): An enlargement of the cornea with normal clarity and function. Megalocornea is diagnosed with a horizontal corneal diameter of 12 mm or more at birth or 13 mm or more after two years of age. Evidence: TAS. Frequency: Occasional (HP:0040283). (ORPHA:280)
- Strabismus (HP:0000486): A misalignment of the eyes so that the visual axes deviate from bifoveal fixation. The classification of strabismus may be based on a number of features including the relative position of the eyes, whether the deviation is latent or manifest, intermittent or constant, concomitant or otherwise and according to the age of onset and the relevance of any associated refractive error. Evidence: TAS. Frequency: Occasional (HP:0040283). (ORPHA:280)
- Retinopathy (HP:0000488): Any noninflammatory disease of the retina. This nonspecific term is retained here because of its wide use in the literature, but if possible new annotations should indicate the precise type of retinal abnormality. Evidence: TAS. Frequency: Occasional (HP:0040283). (ORPHA:280)
- Glaucoma (HP:0000501): Glaucoma refers loss of retinal ganglion cells in a characteristic pattern of optic neuropathy usually associated with increased intraocular pressure. Evidence: TAS. Frequency: Occasional (HP:0040283). (ORPHA:280)
- Proptosis (HP:0000520): An eye that is protruding anterior to the plane of the face to a greater extent than is typical. Evidence: TAS. Frequency: Occasional (HP:0040283). (ORPHA:280)
- Nystagmus (HP:0000639): Rhythmic, involuntary oscillations of one or both eyes related to abnormality in fixation, conjugate gaze, or vestibular mechanisms. Evidence: TAS. Frequency: Occasional (HP:0040283). (ORPHA:280)
- Sclerocornea (HP:0000647): A congenital anomaly in which a part or the whole of the cornea acquires the characteristics of sclera, resulting in clouding of the cornea. Evidence: TAS. Frequency: Occasional (HP:0040283). (ORPHA:280)
- Osteoporosis (HP:0000939): Osteoporosis is a systemic skeletal disease characterized by low bone density and microarchitectural deterioration of bone tissue with a consequent increase in bone fragility. According to the WHO criteria, osteoporosis is defined as a BMD that lies 2.5 standard deviations or more below the average value for young healthy adults (a T-score below -2.5 SD). Evidence: TAS. Frequency: Occasional (HP:0040283). (ORPHA:280)
- Agenesis of corpus callosum (HP:0001274): Absence of the corpus callosum as a result of the failure of the corpus callosum to develop, which can be the result of a failure in any one of the multiple steps of callosal development including cellular proliferation and migration, axonal growth or glial patterning at the midline. Evidence: TAS. Frequency: Occasional (HP:0040283). (ORPHA:280)
- Disproportionate tall stature (HP:0001519): A tall and slim body build with increased arm span to height ratio (>1.05) and a reduced upper-to-lower segment ratio (<0.85), i.e., unusually long arms and legs. The extremities as well as the hands and feet are unusually slim. Evidence: TAS. Frequency: Occasional (HP:0040283). (ORPHA:280)
- Recurrent respiratory infections (HP:0002205): An increased susceptibility to respiratory infections as manifested by a history of recurrent respiratory infections. Evidence: TAS. Frequency: Occasional (HP:0040283). (ORPHA:280)
- Abnormality of the immune system (HP:0002715): An abnormality of the immune system. Evidence: TAS. Frequency: Occasional (HP:0040283). (ORPHA:280)
- Abdominal situs inversus (HP:0003363): A left-right reversal (or mirror reflection) of the anatomical location of the viscera of the abdomen. Evidence: TAS. Frequency: Occasional (HP:0040283). (ORPHA:280)
- Abnormality of the gallbladder (HP:0005264): An abnormality of the gallbladder. Evidence: TAS. Frequency: Occasional (HP:0040283). (ORPHA:280)
- Aplasia/Hypoplasia of the nipples (HP:0006709). Evidence: TAS. Frequency: Occasional (HP:0040283). (ORPHA:280)
- Aplasia/Hypoplasia of the cerebellum (HP:0007360). Evidence: TAS. Frequency: Occasional (HP:0040283). (ORPHA:280)
- Streak ovary (HP:0010464): A developmental disorder characterized by the progressive loss of primordial germ cells in the developing ovaries of an embryo, leading to hypoplastic ovaries composed of wavy connective tissue with occasional clumps of granulosa cells, and frequently mesonephric or hilar cells. Evidence: TAS. Frequency: Occasional (HP:0040283). (ORPHA:280)
- Abnormality of movement (HP:0100022): An abnormality of movement with a neurological basis characterized by changes in coordination and speed of voluntary movements. Evidence: TAS. Frequency: Occasional (HP:0040283). (ORPHA:280)
- Hernia (HP:0100790). Evidence: TAS. Frequency: Occasional (HP:0040283). (ORPHA:280)
- Hypospadias (HP:0000047): Abnormal position of urethral meatus on the ventral penile shaft (underside) characterized by displacement of the urethral meatus from the tip of the glans penis to the ventral surface of the penis, scrotum, or perineum. Evidence: TAS. Frequency: Very frequent (HP:0040281). (ORPHA:280)
- Abnormality of the mouth (HP:0000153): An abnormality of the mouth. Evidence: TAS. Frequency: Very frequent (HP:0040281). (ORPHA:280)
- Abnormal lip morphology (HP:0000159): An abnormality of the lip. Evidence: TAS. Frequency: Very frequent (HP:0040281). (ORPHA:280)
- Microcephaly (HP:0000252): Head circumference below 2 standard deviations below the mean for age and gender. Evidence: TAS. Frequency: Very frequent (HP:0040281). (ORPHA:280)
- Dolichocephaly (HP:0000268): An abnormality of skull shape characterized by a increased anterior-posterior diameter, i.e., an increased antero-posterior dimension of the skull. Cephalic index less than 76%. Alternatively, an apparently increased antero-posterior length of the head compared to width. Often due to premature closure of the sagittal suture. Evidence: TAS. Frequency: Very frequent (HP:0040281). (ORPHA:280)
- Epicanthus (HP:0000286): A fold of skin starting above the medial aspect of the upper eyelid and arching downward to cover, pass in front of and lateral to the medial canthus. Evidence: TAS. Frequency: Very frequent (HP:0040281). (ORPHA:280)
- Abnormality of the philtrum (HP:0000288): An abnormality of the philtrum. Evidence: TAS. Frequency: Very frequent (HP:0040281). (ORPHA:280)
- Hypertelorism (HP:0000316): Interpupillary distance more than 2 SD above the mean (alternatively, the appearance of an increased interpupillary distance or widely spaced eyes). Evidence: TAS. Frequency: Very frequent (HP:0040281). (ORPHA:280)
- Short philtrum (HP:0000322): Distance between nasal base and midline upper lip vermilion border more than 2 SD below the mean. Alternatively, an apparently decreased distance between nasal base and midline upper lip vermilion border. Evidence: TAS. Frequency: Very frequent (HP:0040281). (ORPHA:280)
- Micrognathia (HP:0000347): Developmental hypoplasia of the mandible. Evidence: TAS. Frequency: Very frequent (HP:0040281). (ORPHA:280)
- High forehead (HP:0000348): An abnormally increased height of the forehead. Evidence: TAS. Frequency: Very frequent (HP:0040281). (ORPHA:280)
- Posteriorly rotated ears (HP:0000358): A type of abnormal location of the ears in which the position of the ears is characterized by posterior rotation (the superior part of the ears is rotated towards the back of the head, and the inferior part of the ears towards the front). Evidence: TAS. Frequency: Very frequent (HP:0040281). (ORPHA:280)
- Wide nasal bridge (HP:0000431): Increased breadth of the nasal bridge (and with it, the nasal root). Evidence: TAS. Frequency: Very frequent (HP:0040281). (ORPHA:280)
These phenotypes are associated with the disease Wolf-Hirschhorn syndrome (ORPHA:280).